Phenotypes associated with the disease hearing loss, autosomal recessive 119 (OMIM:619615, an entry in Online Mendelian Inheritance in Man):
- Congenital onset (HP:0003577, a Human Phenotype Ontology term): A phenotypic abnormality that is present at birth. Evidence: PCS. Frequency: 1/3. (PMID:34626583)
- Seizure (HP:0001250, a Human Phenotype Ontology term): A seizure is an intermittent abnormality of nervous system physiology characterized by a transient occurrence of signs and/or symptoms due to abnormal excessive or synchronous neuronal activity in the brain. Evidence: PCS. Frequency: 0/22. (PMID:34626583)
- Sensorineural hearing impairment (HP:0000407, a Human Phenotype Ontology term): A type of hearing impairment in one or both ears related to an abnormal functionality of the cochlear nerve. Evidence: PCS. Frequency: 22/22. (PMID:34626583)
- Childhood onset (HP:0011463, a Human Phenotype Ontology term): Onset of disease at the age of between 1 and 5 years. Evidence: PCS. Frequency: 2/3. (PMID:34626583)
- Global developmental delay (HP:0001263, a Human Phenotype Ontology term): A delay in the achievement of motor or mental milestones in the domains of development of a child, including motor skills, speech and language, cognitive skills, and social and emotional skills. This term should only be used to describe children younger than five years of age. Evidence: PCS. Frequency: 0/22. (PMID:34626583)
- Autosomal recessive inheritance (HP:0000007, a Human Phenotype Ontology term): A mode of inheritance that is observed for traits related to a gene encoded on one of the autosomes (i.e., the human chromosomes 1-22) in which a trait manifests in individuals with two pathogenic alleles, either homozygotes (two copies of the same mutant allele) or compound heterozygotes (whereby each copy of a gene has a distinct mutant allele). Evidence: PCS. (PMID:34626583)
- Intellectual disability (HP:0001249, a Human Phenotype Ontology term): The term intellectual disability or intellectual developmental disorder is used to describe significantly sub-average intellectual and adaptive functioning based on clinical assessment and as measured by individually administered, appropriately normed, standardized and validated tests of intellectual functioning and adaptive behavior, with onset during the developmental period from infancy through adolescence. Evidence: PCS. Frequency: 0/22. (PMID:34626583)